- Impulsivity (HP:0100710): Acting on the spur of the moment or on a momentary basis without consideration of outcomes; having difficulty establishing or following plans; experiencing a sense of urgency and engaging in behavior that is uninhibited, cannot be inhibited, and is uncontrolled. The possibility of repression is inconceivable. Evidence: IEA. (OMIM:300615)
- Diarrhea (HP:0002014): Abnormally increased frequency (usually defined as three or more) loose or watery bowel movements a day. Evidence: IEA. Frequency: Very rare (HP:0040284). (OMIM:300615)
- X-linked recessive inheritance (HP:0001419): A mode of inheritance that is observed for recessive traits related to a gene encoded on the X chromosome. In the context of medical genetics, X-linked recessive disorders manifest in males (who have one copy of the X chromosome and are thus hemizygotes), but generally not in female heterozygotes who have one mutant and one normal allele. Evidence: PCS. (PMID:24169519)
- Flushing (HP:0031284): Recurrent episodes of redness of the skin together with a sensation of warmth or burning of the affected areas of skin. Evidence: IEA. Frequency: Very rare (HP:0040284). (OMIM:300615)
- Aggressive behavior (HP:0000718): Behavior or an act aimed at harming a person, animal, or physical property (e.g., acts of physical violence; shouting, swearing, and using harsh language; slashing someone's tires). Evidence: PCS. (PMID:24169519)
- Autism (HP:0000717): Autism is a neurodevelopmental disorder characterized by impaired social interaction and communication, and by restricted and repetitive behavior. Autism begins in childhood. It is marked by the presence of markedly abnormal or impaired development in social interaction and communication and a markedly restricted repertoire of activity and interest. Manifestations of the disorder vary greatly depending on the developmental level and chronological age of the individual (DSM-IV). Evidence: PCS. (PMID:24169519)
- Kinetic tremor (HP:0030186): Tremor that occurs during any voluntary movement. It may include visually or non-visually guided movements. Tremor during target directed movement is called intention tremor. Evidence: IEA. (OMIM:300615)
- Low frustration tolerance (HP:0000744): The feeling of frustration can be defined as an emotional reaction that occurs when a desired goal is not achieved. Frustration intolerance is defined as an age-inappropriate response to frustration, characterized by crying or temper tantrums in children, or aggressive or other maladaptive behaviors. Evidence: PCS. (PMID:24169519)
- Motor delay (HP:0001270): A type of Developmental delay characterized by a delay in acquiring motor skills. Evidence: TAS. Frequency: Occasional (HP:0040283). (PMID:24169519)
- Self-injurious behavior (HP:0100716): Self-aggression. Evidence: PCS. (PMID:24169519)
- Headache (HP:0002315): Cephalgia, or pain sensed in various parts of the head, not confined to the area of distribution of any nerve. Evidence: IEA. (OMIM:300615)
- Intellectual disability (HP:0001249): The term intellectual disability or intellectual developmental disorder is used to describe significantly sub-average intellectual and adaptive functioning based on clinical assessment and as measured by individually administered, appropriately normed, standardized and validated tests of intellectual functioning and adaptive behavior, with onset during the developmental period from infancy through adolescence. Evidence: PCS. (PMID:24169519)
These phenotypes are associated with the disease Brunner syndrome (OMIM:300615).